- Lumbar kyphosis (HP:0008454): Over curvature of the lumbar region. Evidence: IEA. (OMIM:192900)
- Autosomal dominant inheritance (HP:0000006): A mode of inheritance that is observed for traits related to a gene encoded on one of the autosomes (i.e., the human chromosomes 1-22) in which a trait manifests in heterozygotes. In the context of medical genetics, an autosomal dominant disorder is caused when a single copy of the mutant allele is present. Males and females are affected equally, and can both transmit the disorder with a risk of 50% for each child of inheriting the mutant allele. Evidence: IEA. (OMIM:192900)
- Vertebral hypoplasia (HP:0008417): Small, underdeveloped vertebral bodies. Evidence: IEA. (OMIM:192900)
These phenotypes are associated with the disease vertebral hypoplasia with lumbar kyphosis (OMIM:192900).